Phenotypes associated with the disease febrile seizures, familial, 1 (OMIM:121210):
- Bilateral tonic-clonic seizure (HP:0002069): A bilateral tonic-clonic seizure is a seizure defined by a tonic (bilateral increased tone, lasting seconds to minutes) and then a clonic (bilateral sustained rhythmic jerking) phase. Evidence: IEA. (OMIM:121210)
- Febrile seizure (within the age range of 3 months to 6 years) (HP:0002373): A febrile seizure is any type of seizure (most often a generalized tonic-clonic seizure) occurring with fever (at least 38 degrees Celsius) but in the absence of central nervous system infection, severe metabolic disturbance or other alternative precipitant in children between the ages of 3 months and 6 years. Evidence: IEA. (OMIM:121210)
- Childhood onset (HP:0011463): Onset of disease at the age of between 1 and 5 years. Evidence: IEA. (OMIM:121210)
- Atonic seizure (HP:0010819): Atonic seizure is a type of motor seizure characterized by a sudden loss or diminution of muscle tone without apparent preceding myoclonic or tonic event lasting about 1 to 2 seconds, involving head, trunk, jaw, or limb musculature. Evidence: IEA. (OMIM:121210)
- Generalized tonic seizure (HP:0010818): A generalized tonic seizure is a type of generalized motor seizure characterized by bilateral limb stiffening or elevation, often with neck stiffening without a subsequent clonic phase. The tonic activity can be a sustained abnormal posture, either in extension or flexion, sometimes accompanied by tremor of the extremities. Evidence: IEA. (OMIM:121210)
- Autosomal dominant inheritance (HP:0000006): A mode of inheritance that is observed for traits related to a gene encoded on one of the autosomes (i.e., the human chromosomes 1-22) in which a trait manifests in heterozygotes. In the context of medical genetics, an autosomal dominant disorder is caused when a single copy of the mutant allele is present. Males and females are affected equally, and can both transmit the disorder with a risk of 50% for each child of inheriting the mutant allele. Evidence: IEA. (OMIM:121210)